- Recurrent urinary tract infections (HP:0000010): Repeated infections of the urinary tract. Evidence: TAS. Frequency: Very frequent (HP:0040281). (ORPHA:2704)
- Urinary incontinence (HP:0000020): Loss of the ability to control the urinary bladder leading to involuntary urination. Evidence: TAS. Frequency: Frequent (HP:0040282). (ORPHA:2704)
- Cryptorchidism (HP:0000028): Testis in inguinal canal. That is, absence of one or both testes from the scrotum owing to failure of the testis or testes to descend through the inguinal canal to the scrotum. Evidence: TAS. Frequency: Frequent (HP:0040282). (ORPHA:2704)
- Vesicoureteral reflux (HP:0000076): Abnormal (retrograde) movement of urine from the bladder into ureters or kidneys related to inadequacy of the valvular mechanism at the ureterovesicular junction or other causes. Evidence: TAS. Frequency: Frequent (HP:0040282). (ORPHA:2704)
- Renal insufficiency (HP:0000083): A reduction in the level of performance of the kidneys in areas of function comprising the concentration of urine, removal of wastes, the maintenance of electrolyte balance, homeostasis of blood pressure, and calcium metabolism. Evidence: TAS. Frequency: Occasional (HP:0040283). (ORPHA:2704)
- Hydronephrosis (HP:0000126): Severe distention of the kidney with dilation of the renal pelvis and calices. Evidence: TAS. Frequency: Frequent (HP:0040282). (ORPHA:2704)
- Urethral obstruction (HP:0000796): Obstruction of the flow of urine through the urethra. Evidence: TAS. Frequency: Frequent (HP:0040282). (ORPHA:2704)
- Hypertension (HP:0000822): The presence of chronic increased pressure in the systemic arterial system. Evidence: TAS. Frequency: Occasional (HP:0040283). (ORPHA:2704)
- Polydipsia (HP:0001959): Excessive thirst manifested by excessive fluid intake. Evidence: TAS. Frequency: Occasional (HP:0040283). (ORPHA:2704)
- Constipation (HP:0002019): Infrequent or difficult evacuation of feces. Evidence: TAS. Frequency: Frequent (HP:0040282). (ORPHA:2704)
- Bowel incontinence (HP:0002607): Involuntary fecal soiling in adults and children who have usually already been toilet trained. Evidence: TAS. Frequency: Occasional (HP:0040283). (ORPHA:2704)
These phenotypes are associated with the disease Urofacial syndrome (ORPHA:2704).